- Abdominal pain (HP:0002027): An unpleasant sensation characterized by physical discomfort (such as pricking, throbbing, or aching) and perceived to originate in the abdomen. Evidence: TAS. Frequency: Frequent (HP:0040282). (ORPHA:466677)
- Abnormal involuntary eye movements (HP:0012547): Anomalous movements of the eyes that occur without the subject wanting them to happen. Evidence: TAS. Frequency: Very rare (HP:0040284). (ORPHA:466677)
- Abnormal nasal mucus secretion (HP:0031416): Any deviation from the normal quantity of secretion of nasal mucus, a thick viscous liquid produced by the mucous membranes of the nose. Evidence: TAS. Frequency: Occasional (HP:0040283). (ORPHA:466677)
- Abnormality of acid-base homeostasis (HP:0004360): An abnormality of the balance or maintenance of the balance of acids and bases in bodily fluids, resulting in an abnormal pH. Evidence: TAS. Frequency: Occasional (HP:0040283). (ORPHA:466677)
- Acute kidney injury (HP:0001919): Sudden loss of renal function, as manifested by decreased urine production, and a rise in serum creatinine or blood urea nitrogen concentration (azotemia). Evidence: TAS. Frequency: Very rare (HP:0040284). (ORPHA:466677)
- Acute pancreatitis (HP:0001735): A acute form of pancreatitis. Evidence: TAS. Frequency: Occasional (HP:0040283). (ORPHA:466677)
- Arrhythmia (HP:0011675): Any cardiac rhythm other than the normal sinus rhythm. Such a rhythm may be either of sinus or ectopic origin and either regular or irregular. An arrhythmia may be due to a disturbance in impulse formation or conduction or both. Evidence: TAS. Frequency: Occasional (HP:0040283). (ORPHA:466677)
- Ataxia (HP:0001251): Ataxia refers to impaired coordination of voluntary muscle movement. Cerebellar ataxia refers to ataxia due to dysfunction of the cerebellum. This causes a variety of elementary neurological deficits including asynergy (lack of coordination between muscles, limbs and joints), dysmetria (lack of ability to judge distances that can lead to under- or overshoot in grasping movements), and dysdiadochokinesia (inability to perform rapid movements requiring antagonizing muscle groups to be switched on and off repeatedly). Evidence: TAS. Frequency: Very rare (HP:0040284). (ORPHA:466677)
- Blurred vision (HP:0000622): Lack of sharpness of vision resulting in the inability to see fine detail. Evidence: TAS. Frequency: Very rare (HP:0040284). (ORPHA:466677)
- Bundle branch block (HP:0011710): Block of conduction of electrical impulses along the Bundle of His or along one of its bundle branches. Evidence: TAS. Frequency: Very rare (HP:0040284). (ORPHA:466677)
- Cardiac conduction abnormality (HP:0031546): Any anomaly of the progression of electrical impulses through the heart. Evidence: TAS. Frequency: Frequent (HP:0040282). (ORPHA:466677)
- Cardiogenic shock (HP:0030149): Severely decreased cardiac output with evidence of inadequate end-organ perfusion (i.e., tissue hypoxia) in the presence of adequate intravascular volume. Evidence: TAS. Frequency: Occasional (HP:0040283). (ORPHA:466677)
- Chills (HP:0025143): A sudden sensation of feeling cold. Evidence: TAS. Frequency: Occasional (HP:0040283). (ORPHA:466677)
- Congestive heart failure (HP:0001635): The presence of an abnormality of cardiac function that is responsible for the failure of the heart to pump blood at a rate that is commensurate with the needs of the tissues or a state in which abnormally elevated filling pressures are required for the heart to do so. Heart failure is frequently related to a defect in myocardial contraction. Evidence: TAS. Frequency: Occasional (HP:0040283). (ORPHA:466677)
- Diarrhea (HP:0002014): Abnormally increased frequency (usually defined as three or more) loose or watery bowel movements a day. Evidence: TAS. Frequency: Occasional (HP:0040283). (ORPHA:466677)
- Dysarthria (HP:0001260): Dysarthric speech is a general description referring to a neurological speech disorder characterized by poor articulation. Depending on the involved neurological structures, dysarthria may be further classified as spastic, flaccid, ataxic, hyperkinetic and hypokinetic, or mixed. Evidence: TAS. Frequency: Very rare (HP:0040284). (ORPHA:466677)
- Dyskinesia (HP:0100660): A movement disorder which consists of effects including diminished voluntary movements and the presence of involuntary movements. Evidence: TAS. Frequency: Very rare (HP:0040284). (ORPHA:466677)
- Edema (HP:0000969): An abnormal accumulation of fluid beneath the skin, or in one or more cavities of the body. Evidence: TAS. Frequency: Very frequent (HP:0040281). (ORPHA:466677)
- Elevated circulating aspartate aminotransferase concentration (HP:0031956): The concentration of aspartate aminotransferase (AST) in the blood circulation is above the upper limit of normal. Evidence: TAS. Frequency: Occasional (HP:0040283). (ORPHA:466677)
- Erythema (HP:0010783): Redness of the skin, caused by hyperemia of the capillaries in the lower layers of the skin. Evidence: TAS. Frequency: Very frequent (HP:0040281). (ORPHA:466677)
- Excessive salivation (HP:0003781): Excessive production of saliva. Evidence: TAS. Frequency: Occasional (HP:0040283). (ORPHA:466677)
- Fever (HP:0001945): Body temperature elevated above the normal range. Evidence: TAS. Frequency: Very rare (HP:0040284). (ORPHA:466677)
- Glycosuria (HP:0003076): An increased concentration of glucose in the urine. Evidence: TAS. Frequency: Occasional (HP:0040283). (ORPHA:466677)
- Hemifacial spasm (HP:0010828): Intermittent clonic or tonic contraction of muscles supplied by facial nerve. Muscles are relaxed in between contractions. Evidence: TAS. Frequency: Very rare (HP:0040284). (ORPHA:466677)
- Hyperglycemia (HP:0003074): An increased concentration of glucose in the blood. Evidence: TAS. Frequency: Occasional (HP:0040283). (ORPHA:466677)
- Hyperhidrosis (HP:0000975): Abnormal excessive perspiration (sweating) despite the lack of appropriate stimuli like hot and humid weather. Evidence: TAS. Frequency: Occasional (HP:0040283). (ORPHA:466677)
- Hyperkinetic movements (HP:0002487): Motor hyperactivity with excessive movement of muscles of the body as a whole. Evidence: TAS. Frequency: Very rare (HP:0040284). (ORPHA:466677)
- Hyperreflexia (HP:0001347): Hyperreflexia is the presence of hyperactive stretch reflexes of the muscles. Evidence: TAS. Frequency: Very rare (HP:0040284). (ORPHA:466677)
- Hypertension (HP:0000822): The presence of chronic increased pressure in the systemic arterial system. Evidence: TAS. Frequency: Occasional (HP:0040283). (ORPHA:466677)
- Hypokalemia (HP:0002900): The concentration of potassium(1+) in the blood circulation is below the lower limit of normal. Evidence: TAS. Frequency: Occasional (HP:0040283). (ORPHA:466677)
- Elevated circulating NT-proBNP concentration (HP:0031185): The concentration of NT-proBNP (= N-terminal pro-B-type natriuretic peptide, = N-terminal prohormone of brain natriuretic peptide) in the blood circulation is above the upper limit of normal. Evidence: TAS. Frequency: Occasional (HP:0040283). (ORPHA:466677)
- Elevated circulating CK-MB concentration (HP:0032232): The concentration of CK-MB (= creatine kinase MB) in the blood circulation is above the upper limit of normal. Evidence: TAS. Frequency: Occasional (HP:0040283). (ORPHA:466677)
- Increased circulating lactate dehydrogenase concentration (HP:0025435): An elevated level of the enzyme lactate dehydrogenase in the blood circulation. Evidence: TAS. Frequency: Occasional (HP:0040283). (ORPHA:466677)
- Increased circulating troponin I concentration (HP:0410173): An increased concentration of tropnin I in the blood, which is a cardiac regulatory protein that controls the calcium mediated interaction between actin and myosin. Raised cardiac troponin concentrations are now accepted as the standard biochemical marker for the diagnosis of myocardial infarction. Evidence: TAS. Frequency: Occasional (HP:0040283). (ORPHA:466677)
- Ketonuria (HP:0002919): High levels of ketone bodies (acetoacetic acid, beta-hydroxybutyric acid, and acetone) in the urine. Ketone bodies are insignificant in the blood and urine of normal individuals in the postprandial or overnight-fasted state. Evidence: TAS. Frequency: Very rare (HP:0040284). (ORPHA:466677)
- Miosis (HP:0000616): Abnormal (non-physiological) constriction of the pupil. Evidence: TAS. Frequency: Frequent (HP:0040282). (ORPHA:466677)
- Mixed respiratory and metabolic acidosis (HP:0005967). Evidence: TAS. Frequency: Occasional (HP:0040283). (ORPHA:466677)
- Mydriasis (HP:0011499): Abnormal dilatation of the iris. Evidence: TAS. Frequency: Occasional (HP:0040283). (ORPHA:466677)
- Myocarditis (HP:0012819): Inflammation of the myocardium. Evidence: TAS. Frequency: Very rare (HP:0040284). (ORPHA:466677)
- Myoclonus (HP:0001336): Very brief, involuntary random muscular contractions occurring at rest, in response to sensory stimuli, or accompanying voluntary movements. Evidence: TAS. Frequency: Very rare (HP:0040284). (ORPHA:466677)
- Pain (HP:0012531): An unpleasant sensory and emotional experience associated with actual or potential tissue damage, or described in terms of such damage. Evidence: TAS. Frequency: Very frequent (HP:0040281). (ORPHA:466677)
- Paresthesia (HP:0003401): Abnormal sensations such as tingling, pricking, or numbness of the skin with no apparent physical cause. Evidence: TAS. Frequency: Frequent (HP:0040282). (ORPHA:466677)
- Priapism (HP:0200023): A painful and harmful medical condition in which the erect penis doesn't return to its flaccid state, despite the absence of both physical and psychological stimulation, within four hours. Evidence: TAS. Frequency: Occasional (HP:0040283). (ORPHA:466677)
- Prominent U wave (HP:0025072): Increased amplitude of the U wave, defined as an amplitude greater than 1-2mm or 25 percent of the height of the T wave. Evidence: TAS. Frequency: Occasional (HP:0040283). (ORPHA:466677)
- Pulmonary edema (HP:0100598): Fluid accumulation in the lungs. Evidence: TAS. Frequency: Occasional (HP:0040283). (ORPHA:466677)
- Purpura (HP:0000979): Purpura (from Latin: purpura, meaning purple) is the appearance of red or purple discolorations on the skin that do not blanch on applying pressure. They are caused by bleeding underneath the skin. This term refers to an abnormally increased susceptibility to developing purpura. Purpura are larger than petechiae. Evidence: TAS. Frequency: Occasional (HP:0040283). (ORPHA:466677)
- Respiratory alkalosis (HP:0001950): Alkalosis due to excess loss of carbon dioxide from the body. Evidence: TAS. Frequency: Occasional (HP:0040283). (ORPHA:466677)
- Restlessness (HP:0000711): A state of unease is characterized by diffuse motor activity or motion, which is subject to limited control, nonproductive, or disorganized behavior. Evidence: TAS. Frequency: Frequent (HP:0040282). (ORPHA:466677)
- Rhabdomyolysis (HP:0003201): Breakdown of muscle fibers that leads to the release of muscle fiber contents (myoglobin) into the bloodstream. Evidence: TAS. Frequency: Very rare (HP:0040284). (ORPHA:466677)
- ST segment depression (HP:0012250): An electrocardiographic anomaly in which the ST segment is observed to be located inferior to the isoelectric line. Evidence: TAS. Frequency: Occasional (HP:0040283). (ORPHA:466677)
- Seizure (HP:0001250): A seizure is an intermittent abnormality of nervous system physiology characterized by a transient occurrence of signs and/or symptoms due to abnormal excessive or synchronous neuronal activity in the brain. Evidence: TAS. Frequency: Very rare (HP:0040284). (ORPHA:466677)
- Stroke (HP:0001297): Sudden impairment of blood flow to a part of the brain due to occlusion or rupture of an artery to the brain. Evidence: TAS. Frequency: Very rare (HP:0040284). (ORPHA:466677)
- T-wave inversion (HP:0010872): An inversion of the T-wave (which is normally positive). Evidence: TAS. Frequency: Occasional (HP:0040283). (ORPHA:466677)
- Tachycardia (HP:0001649): A rapid heartrate that exceeds the range of the normal resting heartrate for age. Evidence: TAS. Frequency: Very frequent (HP:0040281). (ORPHA:466677)
- Tachypnea (HP:0002789): Very rapid breathing. Evidence: TAS. Frequency: Occasional (HP:0040283). (ORPHA:466677)
- Tremor (HP:0001337): An unintentional, oscillating to-and-fro muscle movement about a joint axis. Evidence: TAS. Frequency: Occasional (HP:0040283). (ORPHA:466677)
- Premature ventricular contraction (HP:0006682): Premature ventricular contractions (PVC) or ventricular extrasystoles are premature contractions of the heart that arise in response to an impulse in the ventricles rather than the normal impulse from the sinoatrial (SA) node. Evidence: TAS. Frequency: Very rare (HP:0040284). (ORPHA:466677)
- Vomiting (HP:0002013): Forceful ejection of the contents of the stomach through the mouth by means of a series of involuntary spasmic contractions. Evidence: TAS. Frequency: Frequent (HP:0040282). (ORPHA:466677)
These phenotypes are associated with the disease Scorpion envenomation (ORPHA:466677).